Phenotypes associated with the disease Thoraco-abdominal enteric duplication (ORPHA:1759):
- Missing ribs (HP:0000921): A developmental anomaly with absence of one or more ribs. Evidence: TAS. Frequency: Very frequent (HP:0040281). (ORPHA:1759)
- Dextrocardia (HP:0001651): The heart is located in the right hand sided hemithorax. That is, there is a left-right reversal (or "mirror reflection") of the anatomical location of the heart in which the heart is locate on the right side instead of the left. Evidence: TAS. Frequency: Very frequent (HP:0040281). (ORPHA:1759)
- Abnormal tricuspid valve morphology (HP:0001702): Any structural anomaly of the tricuspid valve. Evidence: TAS. Frequency: Very frequent (HP:0040281). (ORPHA:1759)
- Respiratory insufficiency (HP:0002093). Evidence: TAS. Frequency: Very frequent (HP:0040281). (ORPHA:1759)
- Hepatomegaly (HP:0002240): Abnormally increased size of the liver. Evidence: TAS. Frequency: Very frequent (HP:0040281). (ORPHA:1759)
- Meningocele (HP:0002435): Protrusion of the meninges through a defect of the skull or vertebral column. Evidence: TAS. Frequency: Very frequent (HP:0040281). (ORPHA:1759)
- Intestinal malrotation (HP:0002566): An abnormality of the intestinal rotation and fixation that normally occurs during the development of the gut. This can lead to volvulus, or twisting of the intestine that causes obstruction and necrosis. Evidence: TAS. Frequency: Very frequent (HP:0040281). (ORPHA:1759)
- Abnormal dermatoglyphics (HP:0007477): An abnormality of dermatoglyphs (fingerprints), which are present on fingers, palms, toes, and soles. Evidence: TAS. Frequency: Very frequent (HP:0040281). (ORPHA:1759)
- Camptodactyly of finger (HP:0100490): The distal interphalangeal joint and/or the proximal interphalangeal joint of the fingers cannot be extended to 180 degrees by either active or passive extension. Evidence: TAS. Frequency: Very frequent (HP:0040281). (ORPHA:1759)
- Asymmetric growth (HP:0100555): A growth pattern that displays an abnormal difference between the left and the right side. Evidence: TAS. Frequency: Very frequent (HP:0040281). (ORPHA:1759)
- Diastomatomyelia (HP:0100563): Coexistence of two hemicords, at variable levels, causing splaying of the posterior vertebral elements. Results in neurological deficits in lower limb or perineum. Evidence: TAS. Frequency: Very frequent (HP:0040281). (ORPHA:1759)
- Duodenal stenosis (HP:0100867): The narrowing or partial blockage of a portion of the duodenum. Evidence: TAS. Frequency: Very frequent (HP:0040281). (ORPHA:1759)